- Visual field defect (HP:0001123). Evidence: TAS. Frequency: Occasional (HP:0040283). (OMIM:153840)
- Late onset (HP:0003584): A type of adult onset with onset of symptoms after the age of 60 years. Evidence: TAS. (OMIM:153840)
- Reduced visual acuity (HP:0007663). Evidence: TAS. Frequency: Occasional (HP:0040283). (OMIM:153840)
- Visual impairment (HP:0000505): Visual impairment (or vision impairment) is vision loss (of a person) to such a degree as to qualify as an additional support need through a significant limitation of visual capability resulting from either disease, trauma, or congenital or degenerative conditions that cannot be corrected by conventional means, such as refractive correction, medication, or surgery. Evidence: TAS. Frequency: Occasional (HP:0040283). (OMIM:153840)
- Vitelliform macular lesion (HP:0007677): Egg yolk-like (vitelliform) maculopathy is a lesion caused by the accumulation of material, often lipofuscin, in the subretinal space underlying the macula. Lesions may be singular or multiple, and may be either sharply or poorly demarcated. Evidence: TAS. (OMIM:153840)
- Macular dystrophy (HP:0007754): Macular dystrophy is a nonspecific term for retinal degeneration, generally confined to the macula, usually presumed of genetic origin. Evidence: IEA. (OMIM:153840)
- Autosomal dominant inheritance (HP:0000006): A mode of inheritance that is observed for traits related to a gene encoded on one of the autosomes (i.e., the human chromosomes 1-22) in which a trait manifests in heterozygotes. In the context of medical genetics, an autosomal dominant disorder is caused when a single copy of the mutant allele is present. Males and females are affected equally, and can both transmit the disorder with a risk of 50% for each child of inheriting the mutant allele. Evidence: TAS. (OMIM:153840)
These phenotypes are associated with the disease vitelliform macular dystrophy 1 (OMIM:153840).